Phenotypes associated with the disease Papillary tumor of the pineal region (ORPHA:251915):
- Hydrocephalus (HP:0000238): Hydrocephalus is an active distension of the ventricular system of the brain resulting from inadequate passage of CSF from its point of production within the cerebral ventricles to its point of absorption into the systemic circulation. Evidence: TAS. Frequency: Very frequent (HP:0040281). (ORPHA:251915)
- Diplopia (HP:0000651): Diplopia is a condition in which a single object is perceived as two images, it is also known as double vision. Evidence: TAS. Frequency: Very frequent (HP:0040281). (ORPHA:251915)
- Nausea and vomiting (HP:0002017): Nausea is a commonly encountered symptom that has been defined as an unpleasant painless subjective feeling that one will imminently vomit. Vomiting has been defined as the forceful expulsion of the contents of the stomach, duodenum, or jejunum through the oral cavity. While nausea and vomiting are often thought to exist on a temporal continuum, this is not always the case. There are situations when severe nausea may be present without emesis and less frequently, when emesis may be present without preceding nausea. Evidence: TAS. Frequency: Very frequent (HP:0040281). (ORPHA:251915)
- Headache (HP:0002315): Cephalgia, or pain sensed in various parts of the head, not confined to the area of distribution of any nerve. Evidence: TAS. Frequency: Very frequent (HP:0040281). (ORPHA:251915)
- Memory impairment (HP:0002354): An impairment of memory as manifested by a reduced ability to remember things such as dates and names, and increased forgetfulness. Evidence: TAS. Frequency: Very frequent (HP:0040281). (ORPHA:251915)
- Increased intracranial pressure (HP:0002516): An increase of the pressure inside the cranium (skull) and thereby in the brain tissue and cerebrospinal fluid. Evidence: TAS. Frequency: Very frequent (HP:0040281). (ORPHA:251915)
- Abnormal eyelid morphology (HP:0000492): An abnormality of the eyelids. Evidence: TAS. Frequency: Frequent (HP:0040282). (ORPHA:251915)
- Nystagmus (HP:0000639): Rhythmic, involuntary oscillations of one or both eyes related to abnormality in fixation, conjugate gaze, or vestibular mechanisms. Evidence: TAS. Frequency: Frequent (HP:0040282). (ORPHA:251915)
- Episodic ataxia (HP:0002131): Periodic spells of incoordination and imbalance, that is, episodes of ataxia typically lasting from 10 minutes to several hours or days. Evidence: TAS. Frequency: Frequent (HP:0040282). (ORPHA:251915)
- Increased CSF protein concentration (HP:0002922): Increased concentration of protein in the cerebrospinal fluid. Evidence: TAS. Frequency: Frequent (HP:0040282). (ORPHA:251915)
- Altitudinal visual field defect (HP:0030531). Evidence: TAS. Frequency: Frequent (HP:0040282). (ORPHA:251915)
- Cognitive impairment (HP:0100543): Abnormal cognition is characterized by deficits in thinking, reasoning, or remembering. Evidence: TAS. Frequency: Frequent (HP:0040282). (ORPHA:251915)
- Hearing abnormality (HP:0000364): An abnormality of the sensory perception of sound. Evidence: TAS. Frequency: Occasional (HP:0040283). (ORPHA:251915)
- Gait disturbance (HP:0001288): The term gait disturbance can refer to any disruption of the ability to walk. Evidence: TAS. Frequency: Occasional (HP:0040283). (ORPHA:251915)